Phenotypes associated with the disease pancreatic beta cell agenesis with neonatal diabetes mellitus (OMIM:600089):
- Abnormal abdomen morphology (HP:0001438): A structural abnormality of the abdomen ('belly'), that is, the part of the body between the pelvis and the thorax. Evidence: IEA. (OMIM:600089)
- Autosomal recessive inheritance (HP:0000007): A mode of inheritance that is observed for traits related to a gene encoded on one of the autosomes (i.e., the human chromosomes 1-22) in which a trait manifests in individuals with two pathogenic alleles, either homozygotes (two copies of the same mutant allele) or compound heterozygotes (whereby each copy of a gene has a distinct mutant allele). Evidence: IEA. (OMIM:600089)
- Neonatal insulin-dependent diabetes mellitus (HP:0000857). Evidence: IEA. (OMIM:600089)